- Encephalopathy (HP:0001298): Encephalopathy is a term that means brain disease, damage, or malfunction. In general, encephalopathy is manifested by an altered mental state. Evidence: PCS. Frequency: 1/2. (PMID:23596069)
- Congenital onset (HP:0003577): A phenotypic abnormality that is present at birth. Evidence: PCS. Frequency: 2/2. (PMID:23596069)
- Microcephaly (HP:0000252): Head circumference below 2 standard deviations below the mean for age and gender. Evidence: PCS. Frequency: 2/2. (PMID:23596069)
- Seizure (HP:0001250): A seizure is an intermittent abnormality of nervous system physiology characterized by a transient occurrence of signs and/or symptoms due to abnormal excessive or synchronous neuronal activity in the brain. Evidence: PCS. Frequency: 1/2. (PMID:23596069)
- Decreased activity of mitochondrial complex III (HP:0011924): A reduction in the activity of the mitochondrial respiratory chain complex III, which is part of the electron transport chain in mitochondria. Evidence: PCS. Frequency: 2/2. (PMID:23596069)
- Hypotonia (HP:0001252): Hypotonia is an abnormally low muscle tone (the amount of tension or resistance to movement in a muscle). Even when relaxed, muscles have a continuous and passive partial contraction which provides some resistance to passive stretching. Hypotonia thus manifests as diminished resistance to passive stretching. Hypotonia is not the same as muscle weakness, although the two conditions can co-exist. Evidence: PCS. Frequency: 2/2. (PMID:23596069)
- Pulmonary arterial hypertension (HP:0002092): Pulmonary hypertension is defined mean pulmonary artery pressure of 25mmHg or more and pulmonary capillary wedge pressure of 15mmHg or less when measured by right heart catheterisation at rest and in a supine position. Evidence: PCS. Frequency: 1/2. (PMID:23596069)
- Decreased activity of mitochondrial complex I (HP:0011923): A reduction in the activity of the mitochondrial respiratory chain complex I, which is part of the electron transport chain in mitochondria. Evidence: PCS. Frequency: 2/2. (PMID:23596069)
- Depletion of mitochondrial DNA in muscle tissue (HP:0009141). Evidence: PCS. Frequency: 2/2. (PMID:23596069)
- Failure to thrive (HP:0001508): Failure to thrive (FTT) refers to a child whose physical growth is substantially below the norm. Evidence: PCS. Frequency: 1/2. (PMID:23596069)
- Autosomal recessive inheritance (HP:0000007): A mode of inheritance that is observed for traits related to a gene encoded on one of the autosomes (i.e., the human chromosomes 1-22) in which a trait manifests in individuals with two pathogenic alleles, either homozygotes (two copies of the same mutant allele) or compound heterozygotes (whereby each copy of a gene has a distinct mutant allele). Evidence: PCS. (PMID:23596069)
- Congestive heart failure (HP:0001635): The presence of an abnormality of cardiac function that is responsible for the failure of the heart to pump blood at a rate that is commensurate with the needs of the tissues or a state in which abnormally elevated filling pressures are required for the heart to do so. Heart failure is frequently related to a defect in myocardial contraction. Evidence: PCS. Frequency: 1/2. (PMID:23596069)
- Decreased activity of mitochondrial complex IV (HP:0008347): A reduction in the activity of the mitochondrial respiratory chain complex IV, which is part of the electron transport chain in mitochondria. Evidence: PCS. Frequency: 2/2. (PMID:23596069)
- Intrauterine growth retardation (HP:0001511): An abnormal restriction of fetal growth with fetal weight below the tenth percentile for gestational age. Evidence: PCS. Frequency: 1/2. (PMID:23596069)
- Hyperalaninemia (HP:0003348): An increased concentration of alanine in the blood. Evidence: PCS. Frequency: 1/1. (PMID:23596069)
These phenotypes are associated with the disease combined oxidative phosphorylation deficiency 22 (OMIM:616045).